- Non-Mendelian inheritance (HP:0001426, a Human Phenotype Ontology term): A mode of inheritance that depends on genetic determinants in more than one gene. Evidence: PCS. (PMID:15307048)
- Myopia (HP:0000545, a Human Phenotype Ontology term): An abnormality of refraction characterized by the ability to see objects nearby clearly, while objects in the distance appear blurry. Evidence: PCS. (PMID:15307048)
These phenotypes are associated with the disease myopia 7 (OMIM:609256, an entry in Online Mendelian Inheritance in Man).